- Urinary incontinence (HP:0000020): Loss of the ability to control the urinary bladder leading to involuntary urination. Evidence: TAS. Frequency: Very frequent (HP:0040281). (ORPHA:404448)
- Autistic behavior (HP:0000729): Persistent deficits in social interaction and communication and interaction as well as a markedly restricted repertoire of activity and interest as well as repetitive patterns of behavior. Evidence: TAS. Frequency: Very frequent (HP:0040281). (ORPHA:404448)
- Delayed speech and language development (HP:0000750): A degree of language development that is significantly below the norm for a child of a specified age. Evidence: TAS. Frequency: Very frequent (HP:0040281). (ORPHA:404448)
- Global developmental delay (HP:0001263): A delay in the achievement of motor or mental milestones in the domains of development of a child, including motor skills, speech and language, cognitive skills, and social and emotional skills. This term should only be used to describe children younger than five years of age. Evidence: TAS. Frequency: Very frequent (HP:0040281). (ORPHA:404448)
- Abnormal speech pattern (HP:0002167): An abnormality in the sound (volume) or cadence (rate) of speech. Evidence: TAS. Frequency: Very frequent (HP:0040281). (ORPHA:404448)
- Reduced social responsiveness (HP:0012760): A reduced ability to participate in the back-and-forth flow of social interaction appropriate to culture and developmental level, which is normally characterized by an influence of the behavior of one person on the behavior of another person. This results in difficulty interacting with others through emotional, physical, or verbal communication. Evidence: TAS. Frequency: Very frequent (HP:0040281). (ORPHA:404448)
- Compulsive behaviors (HP:0000722): Behavior that consists of repetitive acts, characterized by the feeling that one "has to" perform them, while being aware that these acts are not in line with one's overall goal. Evidence: TAS. Frequency: Frequent (HP:0040282). (ORPHA:404448)
- Anxiety (HP:0000739): Intense feelings of nervousness, tension, or panic often arise in response to interpersonal stresses. There is worry about the negative effects of past unpleasant experiences and future negative possibilities. Individuals may feel fearful, apprehensive, or threatened by uncertainty, and they may also have fears of falling apart or losing control. Evidence: TAS. Frequency: Frequent (HP:0040282). (ORPHA:404448)
- Abnormal finger morphology (HP:0001167): An anomaly of a finger. Evidence: TAS. Frequency: Frequent (HP:0040282). (ORPHA:404448)
- Joint hypermobility (HP:0001382): The capability that a joint (or a group of joints) has to move, passively and/or actively, beyond normal limits along physiological axes. Evidence: TAS. Frequency: Frequent (HP:0040282). (ORPHA:404448)
- Gastroesophageal reflux (HP:0002020): A condition in which the stomach contents leak backwards from the stomach into the esophagus through the lower esophageal sphincter. Evidence: TAS. Frequency: Frequent (HP:0040282). (ORPHA:404448)
- Polyphagia (HP:0002591): A neurological anomaly with gross overeating associated with an abnormally strong desire or need to eat. Evidence: TAS. Frequency: Frequent (HP:0040282). (ORPHA:404448)
- Attention deficit hyperactivity disorder (HP:0007018): Attention deficit hyperactivity disorder (ADHD) manifests at age 2-3 years or by first grade at the latest. The main symptoms are distractibility, impulsivity, hyperactivity, and often trouble organizing tasks and projects, difficulty going to sleep, and social problems from being aggressive, loud, or impatient. Evidence: TAS. Frequency: Frequent (HP:0040282). (ORPHA:404448)
- Floppy infant (HP:0008947): Floppiness/hypotonia is defined as reduced resistance to passive movement of joints. Physical examination of floppy/hypotonic infants shows head lag, lack of shoulder and elbow muscle contraction on traction response, inability to tighten the shoulder girdle muscles (or slipping through) when held under the axillae, scarf sign (when the arm is pulled to the opposite side, the arm wraps around the neck with the elbow crossing midline), hyperdorsiflexion of the feet, easy apposition of the thumb against the forearm, feet touching the cheek with ease and without discomfort, frog leg position, and inverted U sign on ventral suspension (head, arms, and legs hanging down without elbow or knee flexion and the trunk rounded in a dome shape). Evidence: TAS. Frequency: Frequent (HP:0040282). (ORPHA:404448)
- Moderate global developmental delay (HP:0011343): A moderate delay in the achievement of motor or mental milestones in the domains of development of a child. Evidence: TAS. Frequency: Frequent (HP:0040282). (ORPHA:404448)
- Severe global developmental delay (HP:0011344): A severe delay in the achievement of motor or mental milestones in the domains of development of a child. Evidence: TAS. Frequency: Frequent (HP:0040282). (ORPHA:404448)
- Abnormal brain morphology (HP:0012443): A structural abnormality of the brain, which has as its parts the forebrain, midbrain, and hindbrain. Evidence: TAS. Frequency: Frequent (HP:0040282). (ORPHA:404448)
- Chronic constipation (HP:0012450): Constipation for longer than three months with fewer than 3 bowel movements per week, straining, lumpy or hard stools, and a sensation of anorectal obstruction or incomplete defecation. Evidence: TAS. Frequency: Frequent (HP:0040282). (ORPHA:404448)
- Abnormal temper tantrums (HP:0025160): Temper tantrums are brief episodes of extreme, unpleasant, and sometimes aggressive behaviors in response to frustration or anger, which are a normal part of development in toddlers. Temper tantrums that occur more frequently in a given time and/or are more severe in symptomatology and/or longer in duration and/or inappropriate for the given age compared to a temper tantrum that naturally occurs as a part of the developmental process are classified as abnormal temper tantrums. Evidence: TAS. Frequency: Frequent (HP:0040282). (ORPHA:404448)
- Oral-pharyngeal dysphagia (HP:0200136). Evidence: TAS. Frequency: Frequent (HP:0040282). (ORPHA:404448)
- Recurrent urinary tract infections (HP:0000010): Repeated infections of the urinary tract. Evidence: TAS. Frequency: Occasional (HP:0040283). (ORPHA:404448)
- Thick lower lip vermilion (HP:0000179): Increased thickness of the lower lip, leading to a prominent appearance of the lower lip. The height of the vermilion of the lower lip in the midline is more than 2 SD above the mean. Alternatively, an apparently increased height of the vermilion of the lower lip in the frontal view (subjective). Evidence: TAS. Frequency: Occasional (HP:0040283). (ORPHA:404448)
- Thin upper lip vermilion (HP:0000219): Height of the vermilion of the upper lip in the midline more than 2 SD below the mean. Alternatively, an apparently reduced height of the vermilion of the upper lip in the frontal view (subjective). Evidence: TAS. Frequency: Occasional (HP:0040283). (ORPHA:404448)
- Trigonocephaly (HP:0000243): Wedge-shaped, or triangular head, with the apex of the triangle at the midline of the forehead and the base of the triangle at the occiput. Evidence: TAS. Frequency: Occasional (HP:0040283). (ORPHA:404448)
- Smooth philtrum (HP:0000319): Flat skin surface, with no ridge formation in the central region of the upper lip between the nasal base and upper vermilion border. Evidence: TAS. Frequency: Occasional (HP:0040283). (ORPHA:404448)
- Low-set ears (HP:0000369): Upper insertion of the ear to the scalp below an imaginary horizontal line drawn between the inner canthi of the eye and extending posteriorly to the ear. Evidence: TAS. Frequency: Occasional (HP:0040283). (ORPHA:404448)
- Protruding ear (HP:0000411): Angle formed by the plane of the ear and the mastoid bone greater than the 97th centile for age (objective); or, outer edge of the helix more than 2 cm from the mastoid at the point of maximum distance (objective). Evidence: TAS. Frequency: Occasional (HP:0040283). (ORPHA:404448)
- Astigmatism (HP:0000483): A type of refraction error associated with abnormal curvatures on the anterior and/or posterior surface of the cornea. Evidence: TAS. Frequency: Occasional (HP:0040283). (ORPHA:404448)
- Strabismus (HP:0000486): A misalignment of the eyes so that the visual axes deviate from bifoveal fixation. The classification of strabismus may be based on a number of features including the relative position of the eyes, whether the deviation is latent or manifest, intermittent or constant, concomitant or otherwise and according to the age of onset and the relevance of any associated refractive error. Evidence: TAS. Frequency: Occasional (HP:0040283). (ORPHA:404448)
- Hypermetropia (HP:0000540): An abnormality of refraction characterized by the ability to see objects in the distance clearly, while objects nearby appear blurry. Evidence: TAS. Frequency: Occasional (HP:0040283). (ORPHA:404448)
- Aggressive behavior (HP:0000718): Behavior or an act aimed at harming a person, animal, or physical property (e.g., acts of physical violence; shouting, swearing, and using harsh language; slashing someone's tires). Evidence: TAS. Frequency: Occasional (HP:0040283). (ORPHA:404448)
- Single transverse palmar crease (HP:0000954): The distal and proximal transverse palmar creases are merged into a single transverse palmar crease. Evidence: TAS. Frequency: Occasional (HP:0040283). (ORPHA:404448)
- Plagiocephaly (HP:0001357): Asymmetric head shape, which is usually a combination of unilateral occipital flattening with ipsilateral frontal prominence, leading to rhomboid cranial shape. Evidence: TAS. Frequency: Occasional (HP:0040283). (ORPHA:404448)
- Bilateral ptosis (HP:0001488). Evidence: TAS. Frequency: Occasional (HP:0040283). (ORPHA:404448)
- Abnormal nail morphology (HP:0001597): Abnormal structure or appearance of the nail. Evidence: TAS. Frequency: Occasional (HP:0040283). (ORPHA:404448)
- Abnormal toe morphology (HP:0001780): An anomaly of a toe. Evidence: TAS. Frequency: Occasional (HP:0040283). (ORPHA:404448)
- Sandal gap (HP:0001852): A widely spaced gap between the first toe (the great toe) and the second toe. Evidence: TAS. Frequency: Occasional (HP:0040283). (ORPHA:404448)
- Truncal obesity (HP:0001956): Obesity located preferentially in the trunk of the body as opposed to the extremities. Evidence: TAS. Frequency: Occasional (HP:0040283). (ORPHA:404448)
- Vomiting (HP:0002013): Forceful ejection of the contents of the stomach through the mouth by means of a series of involuntary spasmic contractions. Evidence: TAS. Frequency: Occasional (HP:0040283). (ORPHA:404448)
- Cerebral atrophy (HP:0002059): Atrophy (wasting, decrease in size of cells or tissue) affecting the cerebrum. Evidence: TAS. Frequency: Occasional (HP:0040283). (ORPHA:404448)
- Hypoplasia of the corpus callosum (HP:0002079): Underdevelopment of the corpus callosum. Evidence: TAS. Frequency: Occasional (HP:0040283). (ORPHA:404448)
- Ventriculomegaly (HP:0002119): An increase in size of the ventricular system of the brain. Evidence: TAS. Frequency: Occasional (HP:0040283). (ORPHA:404448)
- Sleep disturbance (HP:0002360): An abnormal pattern in the quality, quantity, or characteristics of sleep. Evidence: TAS. Frequency: Occasional (HP:0040283). (ORPHA:404448)
- Developmental regression (HP:0002376): Loss of developmental skills, as manifested by loss of developmental milestones. Evidence: TAS. Frequency: Occasional (HP:0040283). (ORPHA:404448)
- Recurrent upper respiratory tract infections (HP:0002788): An increased susceptibility to upper respiratory tract infections as manifested by a history of recurrent upper respiratory tract infections (running ears - otitis, sinusitis, pharyngitis, tonsillitis). Evidence: TAS. Frequency: Occasional (HP:0040283). (ORPHA:404448)
- Aspiration (HP:0002835): Inspiration of a foreign object into the airway. Evidence: TAS. Frequency: Occasional (HP:0040283). (ORPHA:404448)
- Short stature (HP:0004322): A height below that which is expected according to age and gender norms. Although there is no universally accepted definition of short stature, many refer to "short stature" as height more than 2 standard deviations below the mean for age and gender (or below the 3rd percentile for age and gender dependent norms). Evidence: TAS. Frequency: Occasional (HP:0040283). (ORPHA:404448)
- Impaired mastication (HP:0005216): An abnormal reduction in the ability to masticate (chew), i.e., in the ability to crush and ground food in preparation for swallowing. Evidence: TAS. Frequency: Occasional (HP:0040283). (ORPHA:404448)
- Advanced eruption of teeth (HP:0006288): Premature tooth eruption, which can be defined as tooth eruption more than 2 SD earlier than the mean eruption age. Evidence: TAS. Frequency: Occasional (HP:0040283). (ORPHA:404448)
- Wide intermamillary distance (HP:0006610): A larger than usual distance between the left and right nipple. Evidence: TAS. Frequency: Occasional (HP:0040283). (ORPHA:404448)
- Focal white matter lesions (HP:0007042). Evidence: TAS. Frequency: Occasional (HP:0040283). (ORPHA:404448)
- Microtia (HP:0008551): Underdevelopment of the external ear. Evidence: TAS. Frequency: Occasional (HP:0040283). (ORPHA:404448)
- High anterior hairline (HP:0009890): Distance between the hairline (trichion) and the glabella (the most prominent point on the frontal bone above the root of the nose), in the midline, more than two SD above the mean. Alternatively, an apparently increased distance between the hairline and the glabella. Evidence: TAS. Frequency: Occasional (HP:0040283). (ORPHA:404448)
- Polydactyly (HP:0010442): A congenital anomaly characterized by the presence of supernumerary fingers or toes. Evidence: TAS. Frequency: Occasional (HP:0040283). (ORPHA:404448)
- Mild global developmental delay (HP:0011342): A mild delay in the achievement of motor or mental milestones in the domains of development of a child. Evidence: TAS. Frequency: Occasional (HP:0040283). (ORPHA:404448)
- Gastrostomy tube feeding in infancy (HP:0011471): Feeding problem necessitating gastrostomy tube feeding. Evidence: TAS. Frequency: Occasional (HP:0040283). (ORPHA:404448)
- Abnormal cardiovascular system morphology (HP:0030680): Any structural anomaly of the heart and blood vessels. Evidence: TAS. Frequency: Occasional (HP:0040283). (ORPHA:404448)
- Cerebral visual impairment (HP:0100704): A form of loss of vision caused by damage to the visual cortex rather than a defect in the eye. Evidence: TAS. Frequency: Occasional (HP:0040283). (ORPHA:404448)
- Slanting of the palpebral fissure (HP:0200006). Evidence: TAS. Frequency: Occasional (HP:0040283). (ORPHA:404448)
- Inguinal hernia (HP:0000023): Protrusion of the contents of the abdominal cavity through the inguinal canal. Evidence: TAS. Frequency: Very rare (HP:0040284). (ORPHA:404448)
- Cryptorchidism (HP:0000028): Testis in inguinal canal. That is, absence of one or both testes from the scrotum owing to failure of the testis or testes to descend through the inguinal canal to the scrotum. Evidence: TAS. Frequency: Very rare (HP:0040284). (ORPHA:404448)
- Brachycephaly (HP:0000248): An abnormality of skull shape characterized by a decreased anterior-posterior diameter. That is, a cephalic index greater than 81%. Alternatively, an apparently shortened anteroposterior dimension (length) of the head compared to width. Evidence: TAS. Frequency: Very rare (HP:0040284). (ORPHA:404448)
- Microcephaly (HP:0000252): Head circumference below 2 standard deviations below the mean for age and gender. Evidence: TAS. Frequency: Very rare (HP:0040284). (ORPHA:404448)
- Exotropia (HP:0000577): A form of strabismus with one or both eyes deviated outward. Evidence: TAS. Frequency: Very rare (HP:0040284). (ORPHA:404448)
- Iris coloboma (HP:0000612): A coloboma of the iris. Evidence: TAS. Frequency: Very rare (HP:0040284). (ORPHA:404448)
- Long palpebral fissure (HP:0000637): Distance between medial and lateral canthi is more than two standard deviations above the mean for age (objective); or, apparently increased length of the palpebral fissures. Evidence: TAS. Frequency: Very rare (HP:0040284). (ORPHA:404448)
- Amblyopia (HP:0000646): Reduced visual acuity that is uncorrectable by lenses in the absence of detectable anatomic defects in the eye or visual pathways. Evidence: TAS. Frequency: Very rare (HP:0040284). (ORPHA:404448)
- Hirsutism (HP:0001007): Abnormally increased hair growth referring to a male pattern of body hair (androgenic hair). Evidence: TAS. Frequency: Very rare (HP:0040284). (ORPHA:404448)
- Juvenile cataract (HP:0001118): A type of cataract that is not apparent at birth but that arises in childhood or adolescence. Evidence: TAS. Frequency: Very rare (HP:0040284). (ORPHA:404448)
- Brachydactyly (HP:0001156): Digits that appear disproportionately short compared to the hand/foot. The word brachydactyly is used here to describe a series distinct patterns of shortened digits (brachydactyly types A-E). This is the sense used here. Evidence: TAS. Frequency: Very rare (HP:0040284). (ORPHA:404448)
- Seizure (HP:0001250): A seizure is an intermittent abnormality of nervous system physiology characterized by a transient occurrence of signs and/or symptoms due to abnormal excessive or synchronous neuronal activity in the brain. Evidence: TAS. Frequency: Very rare (HP:0040284). (ORPHA:404448)
- Hypertonia (HP:0001276): A condition in which there is increased muscle tone so that arms or legs, for example, are stiff and difficult to move. Evidence: TAS. Frequency: Very rare (HP:0040284). (ORPHA:404448)
- Umbilical hernia (HP:0001537): Protrusion of abdominal contents through a defect in the abdominal wall musculature around the umbilicus. Skin and subcutaneous tissue overlie the defect. Evidence: TAS. Frequency: Very rare (HP:0040284). (ORPHA:404448)
- Respiratory distress (HP:0002098): Respiratory distress is objectively observable as the physical or emotional consequences from the experience of dyspnea. The physical presentation of respiratory distress is generally referred to as labored breathing, while the sensation of respiratory distress is called shortness of breath or dyspnea. Evidence: TAS. Frequency: Very rare (HP:0040284). (ORPHA:404448)
- Sparse scalp hair (HP:0002209): Decreased number of hairs per unit area of skin of the scalp. Evidence: TAS. Frequency: Very rare (HP:0040284). (ORPHA:404448)
- 2-3 toe syndactyly (HP:0004691): Syndactyly with fusion of toes two and three. Evidence: TAS. Frequency: Very rare (HP:0040284). (ORPHA:404448)
- Depressed nasal bridge (HP:0005280): Posterior positioning of the nasal root in relation to the overall facial profile for age. Evidence: TAS. Frequency: Very rare (HP:0040284). (ORPHA:404448)
- Generalized neonatal hypotonia (HP:0008935): Muscular hypotonia (abnormally low muscle tone) manifesting in the neonatal period and affecting the entire musculature. Evidence: TAS. Frequency: Very rare (HP:0040284). (ORPHA:404448)
- Broad hallux (HP:0010055): Visible increase in width of the hallux without an increase in the dorso-ventral dimension. Evidence: TAS. Frequency: Very rare (HP:0040284). (ORPHA:404448)
- Broad thumb (HP:0011304): Increased thumb width without increased dorso-ventral dimension. Evidence: TAS. Frequency: Very rare (HP:0040284). (ORPHA:404448)
These phenotypes are associated with the disease Helsmoortel-Van der Aa syndrome (ORPHA:404448).